Phenotypes associated with the disease asperger syndrome, susceptibility to, 1 (OMIM:608638):
- Juvenile onset (HP:0003621): Onset of signs or symptoms of disease between the age of 5 and 15 years. Evidence: IEA. (OMIM:608638)
- Reduced ability to form peer relationships (HP:0000728): Difficulty to establish relations with others in a comparable social group (peers) that may be manifested in pehnomena such as not being able to initiative a conversation, understand social cues, or to discuss shared interests. This feature is associated with poor integration within a community or group. Evidence: IEA. (OMIM:608638)
- Autism (HP:0000717): Autism is a neurodevelopmental disorder characterized by impaired social interaction and communication, and by restricted and repetitive behavior. Autism begins in childhood. It is marked by the presence of markedly abnormal or impaired development in social interaction and communication and a markedly restricted repertoire of activity and interest. Manifestations of the disorder vary greatly depending on the developmental level and chronological age of the individual (DSM-IV). Evidence: IEA. (OMIM:608638)
- Restrictive behavior (HP:0000723): Behavior characterized by an abnormal limitation to a few interests and activities. Evidence: TAS. (OMIM:608638)
- Motor stereotypy (HP:0000733): Use of the same abnormal action in response to certain triggers or at random. They may be used as a way to regulate one's internal state but must otherwise have no apparent functional purpose. Evidence: TAS. (OMIM:608638)
- Non-Mendelian inheritance (HP:0001426): A mode of inheritance that depends on genetic determinants in more than one gene. Evidence: IEA. (OMIM:608638)
- Abnormal nonverbal communicative behavior (HP:0000758): Abnormalities in eye contact, communicative facial expressions, gesture use, or the use of others' bodies to communicate convey shared meanings within a culture that replace or supplement verbal communication. Evidence: TAS. (OMIM:608638)
- Sporadic (HP:0003745): Cases of the disease in question occur without a previous family history, i.e., as isolated cases without being transmitted from a parent and without other siblings being affected. Evidence: IEA. (OMIM:608638)
- Lack of spontaneous play (HP:0000721). Evidence: IEA. (OMIM:608638)
- Inflexible adherence to routines (HP:0000732): A need to strictly adhere to repetitive routines or patterns of behavior which are created by the environment. One becomes upset or distressed when their routines are disrupted or altered. Evidence: IEA. (OMIM:608638)
- Autism with high cognitive abilities (HP:0000753). Evidence: IEA. (OMIM:608638)